- Sensory neuropathy (HP:0000763): Peripheral neuropathy affecting the sensory nerves. Evidence: TAS. Frequency: Occasional (HP:0040283). (ORPHA:97330)
- Abnormal rib morphology (HP:0000772): An anomaly of the rib. Evidence: TAS. Frequency: Frequent (HP:0040282). (ORPHA:97330)
- Edema (HP:0000969): An abnormal accumulation of fluid beneath the skin, or in one or more cavities of the body. Evidence: TAS. Frequency: Frequent (HP:0040282). (ORPHA:97330)
- Muscle weakness (HP:0001324): Reduced strength of muscles. Evidence: TAS. Frequency: Frequent (HP:0040282). (ORPHA:97330)
- Varicose veins (HP:0002619): Enlarged and tortuous veins. Evidence: TAS. Frequency: Occasional (HP:0040283). (ORPHA:97330)
- Arthralgia (HP:0002829): Joint pain. Evidence: TAS. Frequency: Frequent (HP:0040282). (ORPHA:97330)
- Myalgia (HP:0003326): Pain in muscle. Evidence: TAS. Frequency: Frequent (HP:0040282). (ORPHA:97330)
- Muscle spasm (HP:0003394): Sudden and involuntary contractions of one or more muscles. Evidence: TAS. Frequency: Occasional (HP:0040283). (ORPHA:97330)
- Paresthesia (HP:0003401): Abnormal sensations such as tingling, pricking, or numbness of the skin with no apparent physical cause. Evidence: TAS. Frequency: Very frequent (HP:0040281). (ORPHA:97330)
- EMG abnormality (HP:0003457): Abnormal results of investigations using electromyography (EMG). Evidence: TAS. Frequency: Occasional (HP:0040283). (ORPHA:97330)
- Venous thrombosis (HP:0004936): Formation of a blood clot (thrombus) inside a vein, causing the obstruction of blood flow. Evidence: TAS. Frequency: Occasional (HP:0040283). (ORPHA:97330)
These phenotypes are associated with the disease Thoracic outlet syndrome (ORPHA:97330).